Phenotypes associated with the disease celiac disease-epilepsy-cerebral calcification syndrome (OMIM:226810):
- Celiac disease (HP:0002608): Celiac disease (CD) is an autoimmune condition affecting the small intestine, triggered by the ingestion of gluten, the protein fraction of wheat, barley, and rye. Clinical manifestations of CD are highly variable and include both gastrointestinal and non-gastrointestinal features. The hallmark of CD is an immune-mediated enteropathy. This term is included because the occurrence of CD is seen as a feature of a number of other diseases. Evidence: IEA. (OMIM:226810)